- Ulcerative colitis (HP:0100279): A chronic inflammatory bowel disease that includes characteristic ulcers, or open sores, in the colon. The main symptom of active disease is usually constant diarrhea mixed with blood, of gradual onset and intermittent periods of exacerbated symptoms contrasting with periods that are relatively symptom-free. In contrast to Crohn's disease this special form of colitis begins in the distal parts of the rectum, spreads continually upwards and affects only mucose and submucose tissue of the colon. Evidence: PCS. (PMID:21983784)
- Crohn's disease (HP:0100280): A chronic granulomatous inflammatory disease of the intestines that may affect any part of the gastrointestinal tract from mouth to anus, causing a wide variety of symptoms. It primarily causes abdominal pain, diarrhea which may be bloody, vomiting, or weight loss, but may also cause complications outside of the gastrointestinal tract such as skin rashes, arthritis, inflammation of the eye, tiredness, and lack of concentration. Crohn's disease is thought to be an autoimmune disease, in which the body's immune system attacks the gastrointestinal tract, causing inflammation. Evidence: PCS. (PMID:21983784)
- Typified by incomplete penetrance (HP:0003829): Description of conditions in which not all individuals with a given genotype exhibit the disease. Penetrance is the proportion that develop disease given a lifespan of 80 years. Evidence: PCS. (PMID:21983784)
- Autosomal dominant inheritance (HP:0000006): A mode of inheritance that is observed for traits related to a gene encoded on one of the autosomes (i.e., the human chromosomes 1-22) in which a trait manifests in heterozygotes. In the context of medical genetics, an autosomal dominant disorder is caused when a single copy of the mutant allele is present. Males and females are affected equally, and can both transmit the disorder with a risk of 50% for each child of inheriting the mutant allele. Evidence: TAS. (PMID:21983784)
These phenotypes are associated with the disease inflammatory bowel disease 29 (OMIM:618077).